Phenotypes associated with the disease hypophosphatemic nephrolithiasis/osteoporosis 2 (OMIM:612287):
- Osteoporosis (HP:0000939): Osteoporosis is a systemic skeletal disease characterized by low bone density and microarchitectural deterioration of bone tissue with a consequent increase in bone fragility. According to the WHO criteria, osteoporosis is defined as a BMD that lies 2.5 standard deviations or more below the average value for young healthy adults (a T-score below -2.5 SD). Evidence: IEA. (OMIM:612287)
- Osteopenia (HP:0000938): Osteopenia is a term to define bone density that is not normal but also not as low as osteoporosis. By definition from the World Health Organization osteopenia is defined by bone densitometry as a T score -1 to -2.5. Evidence: IEA. (OMIM:612287)
- Renal phosphate wasting (HP:0000117): High urine phosphate in the presence of hypophosphatemia. Evidence: IEA. (OMIM:612287)
- Hyperphosphaturia (HP:0003109): An increased excretion of phosphates in the urine. Evidence: IEA. (OMIM:612287)
- Increased susceptibility to fractures (HP:0002659): An abnormally increased tendency to fractures of bones caused by an abnormal reduction in bone strength that is generally associated with an increased risk of fracture. Evidence: IEA. (OMIM:612287)
- Autosomal dominant inheritance (HP:0000006): A mode of inheritance that is observed for traits related to a gene encoded on one of the autosomes (i.e., the human chromosomes 1-22) in which a trait manifests in heterozygotes. In the context of medical genetics, an autosomal dominant disorder is caused when a single copy of the mutant allele is present. Males and females are affected equally, and can both transmit the disorder with a risk of 50% for each child of inheriting the mutant allele. Evidence: IEA. (OMIM:612287)
- Kidney stone (HP:0000787): Kidney stones (calculi) are mineral concretions in the renal calyces and pelvis that are found free or attached to the renal papillae. Evidence: IEA. (OMIM:612287)
- Hypophosphatemia (HP:0002148): The concentration of phosphate ion in the blood circulation is below the lower limit of normal. Evidence: IEA. (OMIM:612287)